Phenotypes associated with the disease Postnatal microcephaly-infantile hypotonia-spastic diplegia-dysarthria-intellectual disability syndrome (ORPHA:477673):
- Microcephaly (HP:0000252): Head circumference below 2 standard deviations below the mean for age and gender. Evidence: TAS. Frequency: Frequent (HP:0040282). (ORPHA:477673)
- Low-set ears (HP:0000369): Upper insertion of the ear to the scalp below an imaginary horizontal line drawn between the inner canthi of the eye and extending posteriorly to the ear. Evidence: TAS. Frequency: Frequent (HP:0040282). (ORPHA:477673)
- Hypotelorism (HP:0000601): Interpupillary distance less than 2 SD below the mean (alternatively, the appearance of an decreased interpupillary distance or closely spaced eyes). Evidence: TAS. Frequency: Frequent (HP:0040282). (ORPHA:477673)
- Delayed speech and language development (HP:0000750): A degree of language development that is significantly below the norm for a child of a specified age. Evidence: TAS. Frequency: Frequent (HP:0040282). (ORPHA:477673)
- Intellectual disability (HP:0001249): The term intellectual disability or intellectual developmental disorder is used to describe significantly sub-average intellectual and adaptive functioning based on clinical assessment and as measured by individually administered, appropriately normed, standardized and validated tests of intellectual functioning and adaptive behavior, with onset during the developmental period from infancy through adolescence. Evidence: TAS. Frequency: Frequent (HP:0040282). (ORPHA:477673)
- Spastic paraplegia (HP:0001258): Complete loss of the ability to move the lower limbs accompanied by spasticity of the lower limbs. Evidence: TAS. Frequency: Frequent (HP:0040282). (ORPHA:477673)
- Dysarthria (HP:0001260): Dysarthric speech is a general description referring to a neurological speech disorder characterized by poor articulation. Depending on the involved neurological structures, dysarthria may be further classified as spastic, flaccid, ataxic, hyperkinetic and hypokinetic, or mixed. Evidence: TAS. Frequency: Frequent (HP:0040282). (ORPHA:477673)
- Global developmental delay (HP:0001263): A delay in the achievement of motor or mental milestones in the domains of development of a child, including motor skills, speech and language, cognitive skills, and social and emotional skills. This term should only be used to describe children younger than five years of age. Evidence: TAS. Frequency: Frequent (HP:0040282). (ORPHA:477673)
- Gait disturbance (HP:0001288): The term gait disturbance can refer to any disruption of the ability to walk. Evidence: TAS. Frequency: Frequent (HP:0040282). (ORPHA:477673)
- Hyperreflexia (HP:0001347): Hyperreflexia is the presence of hyperactive stretch reflexes of the muscles. Evidence: TAS. Frequency: Frequent (HP:0040282). (ORPHA:477673)
- Broad-based gait (HP:0002136): An abnormal gait pattern in which persons stand and walk with their feet spaced widely apart. This is often a component of cerebellar ataxia. Evidence: TAS. Frequency: Frequent (HP:0040282). (ORPHA:477673)
- Drooling (HP:0002307): Habitual flow of saliva out of the mouth. Evidence: TAS. Frequency: Frequent (HP:0040282). (ORPHA:477673)
- Babinski sign (HP:0003487): Upturning of the big toe (and sometimes fanning of the other toes) in response to stimulation of the sole of the foot. If the Babinski sign is present it can indicate damage to the corticospinal tract. Evidence: TAS. Frequency: Frequent (HP:0040282). (ORPHA:477673)
- Severe muscular hypotonia (HP:0006829): A severe degree of muscular hypotonia characterized by markedly reduced muscle tone. Evidence: TAS. Frequency: Frequent (HP:0040282). (ORPHA:477673)
- Nasogastric tube feeding in infancy (HP:0011470): Feeding problem necessitating nasogastric tube feeding. Evidence: TAS. Frequency: Frequent (HP:0040282). (ORPHA:477673)
- Narrow forehead (HP:0000341): Width of the forehead or distance between the frontotemporales is more than two standard deviations below the mean (objective); or apparently narrow intertemporal region (subjective). Evidence: TAS. Frequency: Occasional (HP:0040283). (ORPHA:477673)
- Seizure (HP:0001250): A seizure is an intermittent abnormality of nervous system physiology characterized by a transient occurrence of signs and/or symptoms due to abnormal excessive or synchronous neuronal activity in the brain. Evidence: TAS. Frequency: Occasional (HP:0040283). (ORPHA:477673)
- Tremor (HP:0001337): An unintentional, oscillating to-and-fro muscle movement about a joint axis. Evidence: TAS. Frequency: Occasional (HP:0040283). (ORPHA:477673)
- Failure to thrive (HP:0001508): Failure to thrive (FTT) refers to a child whose physical growth is substantially below the norm. Evidence: TAS. Frequency: Occasional (HP:0040283). (ORPHA:477673)
- Hypoplasia of the corpus callosum (HP:0002079): Underdevelopment of the corpus callosum. Evidence: TAS. Frequency: Occasional (HP:0040283). (ORPHA:477673)
- Febrile seizure (within the age range of 3 months to 6 years) (HP:0002373): A febrile seizure is any type of seizure (most often a generalized tonic-clonic seizure) occurring with fever (at least 38 degrees Celsius) but in the absence of central nervous system infection, severe metabolic disturbance or other alternative precipitant in children between the ages of 3 months and 6 years. Evidence: TAS. Frequency: Occasional (HP:0040283). (ORPHA:477673)
- Abnormal CNS myelination (HP:0011400): An abnormality of myelination of nerves in the central nervous system. Evidence: TAS. Frequency: Occasional (HP:0040283). (ORPHA:477673)